- Abnormality of the dentition (HP:0000164): Any abnormality of the teeth. Evidence: PCS. Frequency: 0/5. (PMID:20544222)
- Abnormal nail morphology (HP:0001597): Abnormal structure or appearance of the nail. Evidence: PCS. Frequency: 0/5. (PMID:20544222)
- Sparse body hair (HP:0002231): Sparseness of the body hair. Evidence: PCS. Frequency: 5/5. (PMID:20544222)
- Sparse scalp hair (HP:0002209): Decreased number of hairs per unit area of skin of the scalp. Evidence: PCS. Frequency: 5/5. (PMID:20544222)
- Autosomal recessive inheritance (HP:0000007): A mode of inheritance that is observed for traits related to a gene encoded on one of the autosomes (i.e., the human chromosomes 1-22) in which a trait manifests in individuals with two pathogenic alleles, either homozygotes (two copies of the same mutant allele) or compound heterozygotes (whereby each copy of a gene has a distinct mutant allele). Evidence: PCS. (PMID:20544222)
- Sparse eyelashes (HP:0000653): Decreased density/number of eyelashes. Evidence: PCS. Frequency: 5/5. (PMID:20544222)
- Sparse eyebrow (HP:0045075): Decreased density/number of eyebrow hairs. Evidence: PCS. Frequency: 5/5. (PMID:20544222)
These phenotypes are associated with the disease hypotrichosis 10 (OMIM:614238).